- Abnormal vestibular function (HP:0001751): An abnormality of the functioning of the vestibular apparatus. Evidence: PCS. Frequency: 0/17. (PMID:21660509)
- Sensorineural hearing impairment (HP:0000407): A type of hearing impairment in one or both ears related to an abnormal functionality of the cochlear nerve. Evidence: PCS. Frequency: 17/17. (PMID:21660509)
- Autosomal recessive inheritance (HP:0000007): A mode of inheritance that is observed for traits related to a gene encoded on one of the autosomes (i.e., the human chromosomes 1-22) in which a trait manifests in individuals with two pathogenic alleles, either homozygotes (two copies of the same mutant allele) or compound heterozygotes (whereby each copy of a gene has a distinct mutant allele). Evidence: PCS. (PMID:21326233)
- Visual impairment (HP:0000505): Visual impairment (or vision impairment) is vision loss (of a person) to such a degree as to qualify as an additional support need through a significant limitation of visual capability resulting from either disease, trauma, or congenital or degenerative conditions that cannot be corrected by conventional means, such as refractive correction, medication, or surgery. Evidence: PCS. Frequency: 0/17. (PMID:21660509)
- Prelingual sensorineural hearing impairment (HP:0000399): A form of sensorineural deafness with either congenital onset or infantile onset, i.e., before the acquisition of speech. Evidence: PCS. Frequency: 2/2. (PMID:21326233)
These phenotypes are associated with the disease autosomal recessive nonsyndromic hearing loss 15 (OMIM:601869).